- Decreased total neutrophil count (HP:0001875): Abnormal decrease of absolute number of neutrophils in the blood, per microlitre, compared to a reference range for a given sex and age-group. Evidence: TAS. Frequency: Very frequent (HP:0040281). (ORPHA:86788)
- Recurrent bacterial infections (HP:0002718): Increased susceptibility to bacterial infections as manifested by recurrent episodes of bacterial infection. Evidence: TAS. Frequency: Very frequent (HP:0040281). (ORPHA:86788)
- Decreased total monocyte count (HP:0012312): Abnormal decrease of absolute number of monocytes in the blood, per microlitre, compared to a reference range for a given sex and age-group. Evidence: TAS. Frequency: Very frequent (HP:0040281). (ORPHA:86788)
These phenotypes are associated with the disease X-linked severe congenital neutropenia (ORPHA:86788).